- Abnormal T cell morphology (HP:0002843): Abnormal increase or decrease of total or subset T cell count. T cells are commonly characterized as CD3+ lymphocytes, or their subpopulations, in the blood, compared to a reference range for a given sex and age-group, measured ex vivo. These may include both TCR alpha/beta and gamma/delta T cells. Evidence: IEA. (OMIM:613949)
This phenotype is associated with the disease Okt4 epitope deficiency (OMIM:613949).